Phenotypes associated with the disease neuronal intestinal dysplasia, type B (OMIM:601223):
- Abnormality of metabolism/homeostasis (HP:0001939). Evidence: IEA. (OMIM:601223)
- Autosomal dominant inheritance (HP:0000006): A mode of inheritance that is observed for traits related to a gene encoded on one of the autosomes (i.e., the human chromosomes 1-22) in which a trait manifests in heterozygotes. In the context of medical genetics, an autosomal dominant disorder is caused when a single copy of the mutant allele is present. Males and females are affected equally, and can both transmit the disorder with a risk of 50% for each child of inheriting the mutant allele. Evidence: IEA. (OMIM:601223)